Phenotypes associated with the disease autosomal dominant nonsyndromic hearing loss 17 (OMIM:603622):
- Juvenile onset (HP:0003621): Onset of signs or symptoms of disease between the age of 5 and 15 years. Evidence: TAS. (OMIM:603622)
- High-frequency hearing impairment (HP:0005101): A type of hearing impairment affecting primarily the higher frequencies of sound (3,000 to 6,000 Hz). Evidence: TAS. (OMIM:603622)
- Autosomal dominant inheritance (HP:0000006): A mode of inheritance that is observed for traits related to a gene encoded on one of the autosomes (i.e., the human chromosomes 1-22) in which a trait manifests in heterozygotes. In the context of medical genetics, an autosomal dominant disorder is caused when a single copy of the mutant allele is present. Males and females are affected equally, and can both transmit the disorder with a risk of 50% for each child of inheriting the mutant allele. Evidence: TAS. (OMIM:603622)